Phenotypes associated with the disease autosomal recessive nonsyndromic hearing loss 13 (OMIM:603098):
- Hearing impairment (HP:0000365): A decreased magnitude of the sensory perception of sound. Evidence: TAS. (PMID:9781028)
- Sensorineural hearing impairment (HP:0000407): A type of hearing impairment in one or both ears related to an abnormal functionality of the cochlear nerve. Evidence: TAS. (PMID:9781028)
- Autosomal recessive inheritance (HP:0000007): A mode of inheritance that is observed for traits related to a gene encoded on one of the autosomes (i.e., the human chromosomes 1-22) in which a trait manifests in individuals with two pathogenic alleles, either homozygotes (two copies of the same mutant allele) or compound heterozygotes (whereby each copy of a gene has a distinct mutant allele). Evidence: TAS. (OMIM:603098)